- Nuclear cataract (HP:0100018): A nuclear cataract is an opacity or clouding that develops in the lens nucleus. That is, a nuclear cataract is one that is located in the center of the lens. The nucleus tends to darken changing from clear to yellow and sometimes brown. Evidence: IEA. (OMIM:615274)
- Congenital onset (HP:0003577): A phenotypic abnormality that is present at birth. Evidence: PCS. Frequency: 18/18. (PMID:10802646)
- Cortical cataract (HP:0100019): A cataract which affects the layer of the lens surrounding the nucleus, i.e., the lens cortex. It is identified by its unique wedge or spoke appearance. Evidence: IEA. Frequency: 1/18. (OMIM:615274)
- Lamellar cataract (HP:0007971): A congenital cataract in which opacity is limited to layers of the lens external to the nucleus (i.e., the perinuclear region), i.e., between the nuclear and cortical layers of the lens. Evidence: PCS. Frequency: 17/18. (PMID:10802646)
- Autosomal dominant inheritance (HP:0000006): A mode of inheritance that is observed for traits related to a gene encoded on one of the autosomes (i.e., the human chromosomes 1-22) in which a trait manifests in heterozygotes. In the context of medical genetics, an autosomal dominant disorder is caused when a single copy of the mutant allele is present. Males and females are affected equally, and can both transmit the disorder with a risk of 50% for each child of inheriting the mutant allele. Evidence: PCS. (PMID:10802646)
These phenotypes are associated with the disease cataract 15 multiple types (OMIM:615274).